- Granuloma (HP:0032252): A compact, organized collection of mature mononuclear phagocytes, which may be but is not necessarily accompanied by accessory features such as necrosis. Evidence: TAS. Frequency: Very frequent (HP:0040281). (ORPHA:781)
- Photophobia (HP:0000613): Excessive sensitivity to light with the sensation of discomfort or pain in the eyes due to exposure to bright light. Evidence: TAS. Frequency: Frequent (HP:0040282). (ORPHA:781)
- Skin rash (HP:0000988): A red eruption of the skin. Evidence: TAS. Frequency: Frequent (HP:0040282). (ORPHA:781)
- Muscle weakness (HP:0001324): Reduced strength of muscles. Evidence: TAS. Frequency: Frequent (HP:0040282). (ORPHA:781)
- Splenomegaly (HP:0001744): Abnormal increased size of the spleen. Evidence: TAS. Frequency: Frequent (HP:0040282). (ORPHA:781)
- Fever (HP:0001945): Body temperature elevated above the normal range. Evidence: TAS. Frequency: Frequent (HP:0040282). (ORPHA:781)
- Diarrhea (HP:0002014): Abnormally increased frequency (usually defined as three or more) loose or watery bowel movements a day. Evidence: TAS. Frequency: Frequent (HP:0040282). (ORPHA:781)
- Nausea and vomiting (HP:0002017): Nausea is a commonly encountered symptom that has been defined as an unpleasant painless subjective feeling that one will imminently vomit. Vomiting has been defined as the forceful expulsion of the contents of the stomach, duodenum, or jejunum through the oral cavity. While nausea and vomiting are often thought to exist on a temporal continuum, this is not always the case. There are situations when severe nausea may be present without emesis and less frequently, when emesis may be present without preceding nausea. Evidence: TAS. Frequency: Frequent (HP:0040282). (ORPHA:781)
- Headache (HP:0002315): Cephalgia, or pain sensed in various parts of the head, not confined to the area of distribution of any nerve. Evidence: TAS. Frequency: Frequent (HP:0040282). (ORPHA:781)
- Elevated circulating hepatic transaminase concentration (HP:0002910): Elevations of the levels of SGOT and SGPT in the serum. SGOT (serum glutamic oxaloacetic transaminase) and SGPT (serum glutamic pyruvic transaminase) are transaminases primarily found in the liver and heart and are released into the bloodstream as the result of liver or heart damage. SGOT and SGPT are used clinically mainly as markers of liver damage. Evidence: TAS. Frequency: Frequent (HP:0040282). (ORPHA:781)
- Myalgia (HP:0003326): Pain in muscle. Evidence: TAS. Frequency: Frequent (HP:0040282). (ORPHA:781)
- Elevated erythrocyte sedimentation rate (HP:0003565): An increased erythrocyte sedimentation rate (ESR). The ESR is a test that measures the distance that erythrocytes have fallen after one hour in a vertical column of anticoagulated blood under the influence of gravity. The ESR is a nonspecific finding. An elevation may indicate inflammation or may be caused by any condition that elevates fibrinogen. Evidence: TAS. Frequency: Frequent (HP:0040282). (ORPHA:781)
- Fatigue (HP:0012378): A subjective feeling of tiredness characterized by a lack of energy and motivation. Evidence: TAS. Frequency: Frequent (HP:0040282). (ORPHA:781)
- Depression (HP:0000716): Frequently experiencing feelings of being down, miserable, and/or hopeless; struggling to recover from these moods; having a pessimistic outlook on the future; feeling a pervasive sense of shame; having a low self-worth; experiencing thoughts of suicide and engaging in suicidal behavior. Evidence: TAS. Frequency: Occasional (HP:0040283). (ORPHA:781)
- Hematuria (HP:0000790): The presence of blood in the urine. Hematuria may be gross hematuria (visible to the naked eye) or microscopic hematuria (detected by dipstick or microscopic examination of the urine). Evidence: TAS. Frequency: Occasional (HP:0040283). (ORPHA:781)
- Jaundice (HP:0000952): Yellow pigmentation of the skin due to bilirubin, which in turn is the result of increased bilirubin concentration in the bloodstream. Evidence: TAS. Frequency: Occasional (HP:0040283). (ORPHA:781)
- Purpura (HP:0000979): Purpura (from Latin: purpura, meaning purple) is the appearance of red or purple discolorations on the skin that do not blanch on applying pressure. They are caused by bleeding underneath the skin. This term refers to an abnormally increased susceptibility to developing purpura. Purpura are larger than petechiae. Evidence: TAS. Frequency: Occasional (HP:0040283). (ORPHA:781)
- Abnormality of the liver (HP:0001392): An abnormality of the liver. Evidence: TAS. Frequency: Occasional (HP:0040283). (ORPHA:781)
- Hepatosplenomegaly (HP:0001433): Simultaneous enlargement of the liver and spleen. Evidence: TAS. Frequency: Occasional (HP:0040283). (ORPHA:781)
- Intrauterine growth retardation (HP:0001511): An abnormal restriction of fetal growth with fetal weight below the tenth percentile for gestational age. Evidence: TAS. Frequency: Occasional (HP:0040283). (ORPHA:781)
- Small for gestational age (HP:0001518): Smaller than normal size according to sex and gestational age related norms, defined as a weight below the 10th percentile for the gestational age. Evidence: TAS. Frequency: Occasional (HP:0040283). (ORPHA:781)
- Oligohydramnios (HP:0001562): Diminished amniotic fluid volume in pregnancy. Evidence: TAS. Frequency: Occasional (HP:0040283). (ORPHA:781)
- Premature birth (HP:0001622): The birth of a baby of less than 37 weeks of gestational age. Evidence: TAS. Frequency: Occasional (HP:0040283). (ORPHA:781)
- Abnormality of the cardiovascular system (HP:0001626): Any abnormality of the cardiovascular system. Evidence: TAS. Frequency: Occasional (HP:0040283). (ORPHA:781)
- Weight loss (HP:0001824): Reduction of total body weight. Evidence: TAS. Frequency: Occasional (HP:0040283). (ORPHA:781)
- Thrombocytopenia (HP:0001873): A reduction in the number of circulating thrombocytes. Evidence: TAS. Frequency: Occasional (HP:0040283). (ORPHA:781)
- Hemolytic anemia (HP:0001878): A type of anemia caused by premature destruction of red blood cells (hemolysis). Evidence: TAS. Frequency: Occasional (HP:0040283). (ORPHA:781)
- Anemia (HP:0001903): A reduction in erythrocytes volume or hemoglobin concentration. Evidence: TAS. Frequency: Occasional (HP:0040283). (ORPHA:781)
- Anorexia (HP:0002039): Lack of desire to eat (loss of appetite). Evidence: TAS. Frequency: Occasional (HP:0040283). (ORPHA:781)
- Pneumonia (HP:0002090): Inflammation of any part of the lung parenchyma. Evidence: TAS. Frequency: Occasional (HP:0040283). (ORPHA:781)
- Hepatomegaly (HP:0002240): Abnormally increased size of the liver. Evidence: TAS. Frequency: Occasional (HP:0040283). (ORPHA:781)
- Sleep disturbance (HP:0002360): An abnormal pattern in the quality, quantity, or characteristics of sleep. Evidence: TAS. Frequency: Occasional (HP:0040283). (ORPHA:781)
- Vasculitis (HP:0002633): Inflammation of blood vessel. Evidence: TAS. Frequency: Occasional (HP:0040283). (ORPHA:781)
- Arthralgia (HP:0002829): Joint pain. Evidence: TAS. Frequency: Occasional (HP:0040283). (ORPHA:781)
- Increased CSF protein concentration (HP:0002922): Increased concentration of protein in the cerebrospinal fluid. Evidence: TAS. Frequency: Occasional (HP:0040283). (ORPHA:781)
- Rheumatoid factor positive (HP:0002923): The presence in the serum of an autoantibody directed against the Fc portion of IgG. Evidence: TAS. Frequency: Occasional (HP:0040283). (ORPHA:781)
- Anti-smooth muscle antibody positivity (HP:0003262): The presence in serum of antibodies against smooth muscle. Evidence: TAS. Frequency: Occasional (HP:0040283). (ORPHA:781)
- Antiphospholipid antibody positivity (HP:0003613): The presence of circulating autoantibodies to phospholipids. Evidence: TAS. Frequency: Occasional (HP:0040283). (ORPHA:781)
- Increased circulating immunoglobulin concentration (HP:0010702): An increased level of gamma globulin (immunoglobulin) in the blood. Evidence: TAS. Frequency: Occasional (HP:0040283). (ORPHA:781)
- Elevated circulating C-reactive protein concentration (HP:0011227): The concentration of C-reactive protein in the blood circulation is above the upper limit of normal. Evidence: TAS. Frequency: Occasional (HP:0040283). (ORPHA:781)
- Hepatitis (HP:0012115): Inflammation of the liver. Evidence: TAS. Frequency: Occasional (HP:0040283). (ORPHA:781)
- Cough (HP:0012735): A sudden, audible expulsion of air from the lungs through a partially closed glottis, preceded by inhalation. Evidence: TAS. Frequency: Occasional (HP:0040283). (ORPHA:781)
- Anticardiolipin IgG antibody positivity (HP:0020136): The presence of circulating IgG autoantibodies to cardiolipin. Evidence: TAS. Frequency: Occasional (HP:0040283). (ORPHA:781)
- Night sweats (HP:0030166): Occurrence of excessive sweating during sleep. Evidence: TAS. Frequency: Occasional (HP:0040283). (ORPHA:781)
- Non-infectious meningitis (HP:0033430): Inflammation of the layers of tissue that cover the brain and spinal cord (meninges) and of the fluid-filled space between the meninges (subarachnoid space) when it is caused by disorders that are not infections or by drugs or vaccines. Evidence: TAS. Frequency: Occasional (HP:0040283). (ORPHA:781)
- Maculopapular exanthema (HP:0040186): A skin rash that is characterized by diffuse cutaneous erythema with areas of skin elevation. It may evolve to vesicles or papules as part of a more severe clinical entity. Different degrees of angioedema with involvement of subcutaneous tissue may also appear. Evidence: TAS. Frequency: Occasional (HP:0040283). (ORPHA:781)
- Endocarditis (HP:0100584): An inflammation of the endocardium, the inner layer of the heart, which usually involves the heart valves. Evidence: TAS. Frequency: Occasional (HP:0040283). (ORPHA:781)
- Cholecystitis (HP:0001082): The presence of inflammatory changes in the gallbladder. Evidence: TAS. Frequency: Very rare (HP:0040284). (ORPHA:781)
- Meningitis (HP:0001287): Inflammation of the meninges. Evidence: TAS. Frequency: Very rare (HP:0040284). (ORPHA:781)
- Pericardial effusion (HP:0001698): Accumulation of fluid within the pericardium. Evidence: TAS. Frequency: Very rare (HP:0040284). (ORPHA:781)
- Pericarditis (HP:0001701): Inflammation of the sac-like covering around the heart (pericardium). Evidence: TAS. Frequency: Very rare (HP:0040284). (ORPHA:781)
- Respiratory distress (HP:0002098): Respiratory distress is objectively observable as the physical or emotional consequences from the experience of dyspnea. The physical presentation of respiratory distress is generally referred to as labored breathing, while the sensation of respiratory distress is called shortness of breath or dyspnea. Evidence: TAS. Frequency: Very rare (HP:0040284). (ORPHA:781)
- Pleural effusion (HP:0002202): The presence of an excessive amount of fluid in the pleural cavity. Evidence: TAS. Frequency: Very rare (HP:0040284). (ORPHA:781)
- Infectious encephalitis (HP:0002383): A disorder of the brain caused by an infectious agent that presents with fever, headache, and an altered level of consciousness. There may also be focal or multifocal neurologic deficits, and focal or generalized seizure activity. Evidence: TAS. Frequency: Very rare (HP:0040284). (ORPHA:781)
- Lymphadenopathy (HP:0002716): Enlargement (swelling) of a lymph node. Evidence: TAS. Frequency: Very rare (HP:0040284). (ORPHA:781)
- Osteomyelitis (HP:0002754): Osteomyelitis is an inflammatory process accompanied by bone destruction and caused by an infecting microorganism. Evidence: TAS. Frequency: Very rare (HP:0040284). (ORPHA:781)
- Abnormal left ventricular function (HP:0005162): Inability of the left ventricle to perform its normal physiologic function. Failure is either due to an inability to contract the left ventricle or the inability to relax completely and fill with blood during diastole. Evidence: TAS. Frequency: Very rare (HP:0040284). (ORPHA:781)
- Abnormal pulmonary interstitial morphology (HP:0006530): Abnormality of the lung parenchyma extending to the pulmonary interstitium and leading to diffuse pulmonary fibrosis. Evidence: TAS. Frequency: Very rare (HP:0040284). (ORPHA:781)
- Amyloid deposition (HP:0011034): Pathologic deposits of specific fibrillar protein aggregates with distinct microscopic properties, particularly affinity for the dye Congo red with typical birefringence. Evidence: TAS. Frequency: Very rare (HP:0040284). (ORPHA:781)
- Myocarditis (HP:0012819): Inflammation of the myocardium. Evidence: TAS. Frequency: Very rare (HP:0040284). (ORPHA:781)
- Lupus anticoagulant (HP:0025343): Presence of lupus anticoagulant (LA) autoantibodies. LA represent a heterogeneous group of autoantibodies, IgG, IgM, or a mixture of both classes, that interfere with standard phospholipid-based coagulant tests (this is only an in vitro phenomenon, LA do not cause reduction of coagulation in vivo). The antibodies are directed against plasma proteins which also bind to phospholipid surfaces. Evidence: TAS. Frequency: Very rare (HP:0040284). (ORPHA:781)
- Cryoglobulinemia (HP:0100778): Increased level of cryoglobulins in the blood. Cryoglobulins are abnormal immunoglobulins, especially IGG or IGM, that precipitate spontaneously when serum is cooled below 37 degrees Celsius. Evidence: TAS. Frequency: Very rare (HP:0040284). (ORPHA:781)
These phenotypes are associated with the disease Q fever (ORPHA:781).